Phenotypes associated with the disease mitochondrial complex I deficiency, nuclear type 13 (OMIM:618235):
- Encephalopathy (HP:0001298): Encephalopathy is a term that means brain disease, damage, or malfunction. In general, encephalopathy is manifested by an altered mental state. Evidence: PCS. Frequency: 1/2. (PMID:28857146)
- Bilateral tonic-clonic seizure (HP:0002069): A bilateral tonic-clonic seizure is a seizure defined by a tonic (bilateral increased tone, lasting seconds to minutes) and then a clonic (bilateral sustained rhythmic jerking) phase. Evidence: PCS. Frequency: 1/1. (PMID:18513682)
- Decreased circulating carnitine concentration (HP:0003234): Concentration of carnitine in the blood circulation below the lower limit of normal. Evidence: PCS. Frequency: 1/2. (PMID:28857146)
- Cardiac arrest (HP:0001695): An abrupt loss of heart function. Evidence: PCS. Frequency: 1/1. (PMID:18513682)
- Infantile onset (HP:0003593): Onset of signs or symptoms of disease between 28 days to one year of life. Evidence: PCS. Frequency: 1/2. (PMID:28857146)
- Hepatomegaly (HP:0002240): Abnormally increased size of the liver. Evidence: PCS. Frequency: 1/2. (PMID:28857146)
- Failure to thrive (HP:0001508): Failure to thrive (FTT) refers to a child whose physical growth is substantially below the norm. Evidence: PCS. Frequency: 1/2. (PMID:28857146)
- Irritability (HP:0000737): An emotional state characterized by negative feelings of heightened frustration, annoyance, or feeling upset, often triggered by internal factors (e.g., fatigue, hunger, unfulfilled desires) or external factors (e.g., social or environmental challenges). Irritability may be unpredictable, and is accompanied by a lowered threshold for emotional reactivity and observable features (speech, facial expressions, or psychomotor activity). Evidence: PCS. Frequency: 1/2. (PMID:28857146)
- Fever (HP:0001945): Body temperature elevated above the normal range. Evidence: PCS. Frequency: 1/2. (PMID:28857146)
- Generalized dystonia (HP:0007325): A type of dystonia that affects all or most of the body. Evidence: PCS. Frequency: 1/2. (PMID:28857146)
- Death in infancy (HP:0001522): Death within the first 24 months of life. Evidence: PCS. Frequency: 1/1. (PMID:18513682)
- Metabolic acidosis (HP:0001942): Metabolic acidosis (MA) is characterized by a fall in blood pH due to a reduction of serum bicarbonate concentration. This can occur as a result of either the accumulation of acids (high anion gap MA) or the loss of bicarbonate from the gastrointestinal tract or the kidney (hyperchloremic MA). By definition, MA is not due to a respirary cause. Evidence: IEA. (OMIM:618235)
- Intellectual disability (HP:0001249): The term intellectual disability or intellectual developmental disorder is used to describe significantly sub-average intellectual and adaptive functioning based on clinical assessment and as measured by individually administered, appropriately normed, standardized and validated tests of intellectual functioning and adaptive behavior, with onset during the developmental period from infancy through adolescence. Evidence: PCS. Frequency: 1/1. (PMID:28857146)
- Neonatal onset (HP:0003623): Onset of signs or symptoms of disease within the first 28 days of life. Evidence: PCS. Frequency: 1/1. (PMID:18513682)
- Acidosis (HP:0001941): Abnormal acid accumulation or depletion of base. Evidence: PCS. Frequency: 1/1. (PMID:18513682)
- Microcephaly (HP:0000252): Head circumference below 2 standard deviations below the mean for age and gender. Evidence: PCS. Frequency: 1/2. (PMID:28857146)
- Cerebral atrophy (HP:0002059): Atrophy (wasting, decrease in size of cells or tissue) affecting the cerebrum. Evidence: PCS. Frequency: 1/1. (PMID:18513682)
- Vomiting (HP:0002013): Forceful ejection of the contents of the stomach through the mouth by means of a series of involuntary spasmic contractions. Evidence: PCS. Frequency: 1/1. (PMID:18513682)
- Hypoplasia of the corpus callosum (HP:0002079): Underdevelopment of the corpus callosum. Evidence: PCS. Frequency: 1/1. (PMID:18513682)
- Developmental regression (HP:0002376): Loss of developmental skills, as manifested by loss of developmental milestones. Evidence: PCS. Frequency: 2/2. (PMID:28857146)
- Bradycardia (HP:0001662): A slower than normal heart rate (in adults, slower than 60 beats per minute). Evidence: PCS. Frequency: 1/1. (PMID:18513682)
- Feeding difficulties (HP:0011968): Impaired ability to eat related to problems gathering food and getting ready to suck, chew, or swallow it. Evidence: PCS. Frequency: 1/2. (PMID:28857146)
- Global developmental delay (HP:0001263): A delay in the achievement of motor or mental milestones in the domains of development of a child, including motor skills, speech and language, cognitive skills, and social and emotional skills. This term should only be used to describe children younger than five years of age. Evidence: PCS. Frequency: 3/3. (PMID:28857146;PMID:18513682)
- Decreased activity of mitochondrial complex I (HP:0011923): A reduction in the activity of the mitochondrial respiratory chain complex I, which is part of the electron transport chain in mitochondria. Evidence: PCS. Frequency: 3/3. (PMID:28857146;PMID:18513682)
- Reduced cerebral white matter volume (HP:0034295): An abnormally low volume of the white matter of the brain. Evidence: PCS. Frequency: 1/2. (PMID:28857146)
- Hypertrophic cardiomyopathy (HP:0001639): Hypertrophic cardiomyopathy (HCM) is defined by the presence of increased ventricular wall thickness or mass in the absence of loading conditions (hypertension, valve disease) sufficient to cause the observed abnormality. Evidence: PCS. Frequency: 1/1. Onset: Neonatal onset (HP:0003623). (PMID:18513682)
- Focal motor seizure (HP:0011153): A type of focal-onset seizure characterized by a motor sign as its initial semiological manifestation. Evidence: PCS. Frequency: 1/2. (PMID:28857146)
- Autosomal recessive inheritance (HP:0000007): A mode of inheritance that is observed for traits related to a gene encoded on one of the autosomes (i.e., the human chromosomes 1-22) in which a trait manifests in individuals with two pathogenic alleles, either homozygotes (two copies of the same mutant allele) or compound heterozygotes (whereby each copy of a gene has a distinct mutant allele). Evidence: PCS. (PMID:18513682)
- Spasticity (HP:0001257): A motor disorder characterized by a velocity-dependent increase in tonic stretch reflexes with increased muscle tone, exaggerated (hyperexcitable) tendon reflexes. Evidence: PCS. Frequency: 1/2. (PMID:28857146)
- Apnea (HP:0002104): Lack of breathing with no movement of the respiratory muscles and no exchange of air in the lungs. This term refers to a disposition to have recurrent episodes of apnea rather than to a single event. Evidence: PCS. Frequency: 1/1. (PMID:18513682)
- Coma (HP:0001259): The complete absence of wakefulness and consciousness, which is evident through a lack of response to any form of external stimuli. Evidence: PCS. Frequency: 1/1. (PMID:18513682)